Phenotypes associated with the disease Conductive deafness-ptosis-skeletal anomalies syndrome (ORPHA:3236):
- Abnormal palate morphology (HP:0000174): Any abnormality of the palate, i.e., of roof of the mouth. Evidence: TAS. Frequency: Frequent (HP:0040282). (ORPHA:3236)
- Epicanthus (HP:0000286): A fold of skin starting above the medial aspect of the upper eyelid and arching downward to cover, pass in front of and lateral to the medial canthus. Evidence: TAS. Frequency: Very frequent (HP:0040281). (ORPHA:3236)
- Conductive hearing impairment (HP:0000405): An abnormality of vibrational conductance of sound to the inner ear leading to impairment of sensory perception of sound. Evidence: TAS. Frequency: Very frequent (HP:0040281). (ORPHA:3236)
- Atresia of the external auditory canal (HP:0000413): Absence or failure to form of the external auditory canal. Evidence: TAS. Frequency: Very frequent (HP:0040281). (ORPHA:3236)
- Narrow nasal bridge (HP:0000446): Decreased width of the bony bridge of the nose. Evidence: TAS. Frequency: Very frequent (HP:0040281). (ORPHA:3236)
- Ptosis (HP:0000508): The upper eyelid margin is positioned 3 mm or more lower than usual and covers the superior portion of the iris (objective); or, the upper lid margin obscures at least part of the pupil (subjective). Evidence: TAS. Frequency: Very frequent (HP:0040281). (ORPHA:3236)
- Myopia (HP:0000545): An abnormality of refraction characterized by the ability to see objects nearby clearly, while objects in the distance appear blurry. Evidence: TAS. Frequency: Frequent (HP:0040282). (ORPHA:3236)
- Blepharophimosis (HP:0000581): A fixed reduction in the vertical distance between the upper and lower eyelids with short palpebral fissures. Evidence: TAS. Frequency: Very frequent (HP:0040281). (ORPHA:3236)
- Abnormal dental enamel morphology (HP:0000682): An abnormality of the dental enamel. Evidence: TAS. Frequency: Very frequent (HP:0040281). (ORPHA:3236)
- Fine hair (HP:0002213): Hair that is fine or thin to the touch. Evidence: TAS. Frequency: Very frequent (HP:0040281). (ORPHA:3236)
- Elbow dislocation (HP:0003042): Dislocation of the distal humerus out of the elbow joint, where the radius, ulna, and humerus meet. Evidence: TAS. Frequency: Very frequent (HP:0040281). (ORPHA:3236)
- Abnormal hip bone morphology (HP:0003272): An abnormality of the hip bone. Evidence: TAS. Frequency: Very frequent (HP:0040281). (ORPHA:3236)
- Clinodactyly of the 5th finger (HP:0004209): Clinodactyly refers to a bending or curvature of the fifth finger in the radial direction (i.e., towards the 4th finger). Evidence: TAS. Frequency: Very frequent (HP:0040281). (ORPHA:3236)
- Abnormal dermatoglyphics (HP:0007477): An abnormality of dermatoglyphs (fingerprints), which are present on fingers, palms, toes, and soles. Evidence: TAS. Frequency: Very frequent (HP:0040281). (ORPHA:3236)
- Bilateral single transverse palmar creases (HP:0007598): The distal and proximal transverse palmar creases are merged into a single transverse palmar crease on both hands. Evidence: TAS. Frequency: Frequent (HP:0040282). (ORPHA:3236)
- Aplasia/Hypoplasia of the middle ear (HP:0008773): Aplasia or developmental hypoplasia of all or part of the middle ear. Evidence: TAS. Frequency: Very frequent (HP:0040281). (ORPHA:3236)